- Abnormality of eye movement (HP:0000496): An abnormality in voluntary or involuntary eye movements or their control. Evidence: TAS. Frequency: Very frequent (HP:0040281). (ORPHA:1179)
- Nystagmus (HP:0000639): Rhythmic, involuntary oscillations of one or both eyes related to abnormality in fixation, conjugate gaze, or vestibular mechanisms. Evidence: TAS. Frequency: Very frequent (HP:0040281). (ORPHA:1179)
- Episodic ataxia (HP:0002131): Periodic spells of incoordination and imbalance, that is, episodes of ataxia typically lasting from 10 minutes to several hours or days. Evidence: TAS. Frequency: Very frequent (HP:0040281). (ORPHA:1179)
These phenotypes are associated with the disease Benign paroxysmal tonic upgaze of childhood with ataxia (ORPHA:1179).